- Milia (HP:0001056): Presence of multiple small cysts containing keratin (skin protein) and presenting as tiny pearly-white bumps just under the surface of the skin. Evidence: TAS. (OMIM:157400)
- Autosomal dominant inheritance (HP:0000006): A mode of inheritance that is observed for traits related to a gene encoded on one of the autosomes (i.e., the human chromosomes 1-22) in which a trait manifests in heterozygotes. In the context of medical genetics, an autosomal dominant disorder is caused when a single copy of the mutant allele is present. Males and females are affected equally, and can both transmit the disorder with a risk of 50% for each child of inheriting the mutant allele. Evidence: IEA. (OMIM:157400)
These phenotypes are associated with the disease milia, multiple eruptive (OMIM:157400).